Phenotypes associated with the disease ichthyotic keratoderma, spasticity, hypomyelination, and dysmorphic facial features (OMIM:618527):
- Constriction of peripheral visual field (HP:0001133): An absolute or relative decrease in retinal sensitivity extending from edge (periphery) of the visual field in a concentric pattern. The visual field is the area that is perceived simultaneously by a fixating eye. Evidence: PCS. Frequency: 1/2. (PMID:29496980)
- Parakeratosis (HP:0001036): Abnormal formation of the keratinocytes of the epidermis characterized by persistence of nuclei, incomplete formation of keratin, and moistness and swelling of the keratinocytes. Evidence: PCS. Frequency: 2/2. (PMID:29496980)
- Dysmetria (HP:0001310): A type of ataxia characterized by the inability to carry out movements with the correct range and motion across the plane of more than one joint related to incorrect estimation of the distances required for targeted movements. Evidence: PCS. Frequency: 1/2. (PMID:29496980)
- Ataxia (HP:0001251): Ataxia refers to impaired coordination of voluntary muscle movement. Cerebellar ataxia refers to ataxia due to dysfunction of the cerebellum. This causes a variety of elementary neurological deficits including asynergy (lack of coordination between muscles, limbs and joints), dysmetria (lack of ability to judge distances that can lead to under- or overshoot in grasping movements), and dysdiadochokinesia (inability to perform rapid movements requiring antagonizing muscle groups to be switched on and off repeatedly). Evidence: PCS. Frequency: 2/2. (PMID:29496980)
- Infantile onset (HP:0003593): Onset of signs or symptoms of disease between 28 days to one year of life. Evidence: PCS. Frequency: 2/2. (PMID:29496980)
- Motor delay (HP:0001270): A type of Developmental delay characterized by a delay in acquiring motor skills. Evidence: PCS. Frequency: 2/2. (PMID:29496980)
- Nystagmus (HP:0000639): Rhythmic, involuntary oscillations of one or both eyes related to abnormality in fixation, conjugate gaze, or vestibular mechanisms. Evidence: PCS. Frequency: 2/2. (PMID:29496980)
- Dry skin (HP:0000958): Skin characterized by the lack of natural or normal moisture. Evidence: PCS. Frequency: 2/2. (PMID:29496980)
- Xerostomia (HP:0000217): Dryness of the mouth due to salivary gland dysfunction. Evidence: PCS. Frequency: 1/2. (PMID:29496980)
- Photophobia (HP:0000613): Excessive sensitivity to light with the sensation of discomfort or pain in the eyes due to exposure to bright light. Evidence: PCS. Frequency: 1/2. (PMID:29496980)
- Reduced visual acuity (HP:0007663). Evidence: IEA. (OMIM:618527)
- Acanthosis nigricans (HP:0000956): A dermatosis characterized by thickened, hyperpigmented plaques, typically on the intertriginous surfaces and neck. Evidence: IEA. (OMIM:618527)
- CNS hypomyelination (HP:0003429): Reduced amount of myelin in the central nervous system resulting from defective myelinogenesis. Evidence: PCS. Frequency: 1/2. (PMID:29496980)
- Brisk reflexes (HP:0001348): Tendon reflexes that are noticeably more active than usual (conventionally denoted 3+ on clinical examination). Brisk reflexes may or may not indicate a neurological lesion. They are distinguished from hyperreflexia by the fact that hyerreflexia is characterized by hyperactive repeating (clonic) reflexes, which are considered to be always abnormal. Evidence: PCS. Frequency: 1/2. (PMID:29496980)
- Intellectual disability (HP:0001249): The term intellectual disability or intellectual developmental disorder is used to describe significantly sub-average intellectual and adaptive functioning based on clinical assessment and as measured by individually administered, appropriately normed, standardized and validated tests of intellectual functioning and adaptive behavior, with onset during the developmental period from infancy through adolescence. Evidence: PCS. Frequency: 0/2. (PMID:29496980)
- Neurogenic bladder (HP:0000011): A type of bladder dysfunction caused by neurologic damage. Neurogenic bladder can be flaccid or spastic. Common manifestatios of neurogenic bladder are overflow incontinence, frequency, urgency, urge incontinence, and retention. Evidence: IEA. (OMIM:618527)
- Rotary nystagmus (HP:0001583): A form of nystagmus in which the eyeball makes rotary motions around the axis. Evidence: PCS. Frequency: 1/2. (PMID:29496980)
- Babinski sign (HP:0003487): Upturning of the big toe (and sometimes fanning of the other toes) in response to stimulation of the sole of the foot. If the Babinski sign is present it can indicate damage to the corticospinal tract. Evidence: PCS. Frequency: 1/2. (PMID:29496980)
- Dysarthria (HP:0001260): Dysarthric speech is a general description referring to a neurological speech disorder characterized by poor articulation. Depending on the involved neurological structures, dysarthria may be further classified as spastic, flaccid, ataxic, hyperkinetic and hypokinetic, or mixed. Evidence: PCS. Frequency: 1/2. (PMID:29496980)
- Epidermal acanthosis (HP:0025092): Diffuse hypertrophy or thickening of the stratum spinosum of the epidermis (prickle cell layer of the skin). Evidence: PCS. Frequency: 2/2. (PMID:29496980)
- Ichthyosis (HP:0008064): An abnormality of the skin characterized the presence of excessive amounts of dry surface scales on the skin resulting from an abnormality of keratinization. Evidence: PCS. Frequency: 2/2. (PMID:29496980)
- Sensorineural hearing impairment (HP:0000407): A type of hearing impairment in one or both ears related to an abnormal functionality of the cochlear nerve. Evidence: PCS. Frequency: 2/2. (PMID:29496980)
- Spastic paraplegia (HP:0001258): Complete loss of the ability to move the lower limbs accompanied by spasticity of the lower limbs. Evidence: PCS. Frequency: 2/2. (PMID:29496980)
- Optic disc pallor (HP:0000543): A pale yellow discoloration of the optic disc (the area of the optic nerve head in the retina). The optic disc normally has a pinkish hue with a central yellowish depression. Evidence: PCS. Frequency: 1/2. (PMID:29496980)
- Spasticity (HP:0001257): A motor disorder characterized by a velocity-dependent increase in tonic stretch reflexes with increased muscle tone, exaggerated (hyperexcitable) tendon reflexes. Evidence: PCS. Frequency: 2/2. (PMID:29496980)
- Tremor (HP:0001337): An unintentional, oscillating to-and-fro muscle movement about a joint axis. Evidence: PCS. Frequency: 1/2. (PMID:29496980)
- Autosomal dominant inheritance (HP:0000006): A mode of inheritance that is observed for traits related to a gene encoded on one of the autosomes (i.e., the human chromosomes 1-22) in which a trait manifests in heterozygotes. In the context of medical genetics, an autosomal dominant disorder is caused when a single copy of the mutant allele is present. Males and females are affected equally, and can both transmit the disorder with a risk of 50% for each child of inheriting the mutant allele. Evidence: PCS. (PMID:29496980)
- Hyperkeratosis (HP:0000962): Hyperkeratosis is a histopathological term defining a thickened stratum corneum and may be present in many different skin conditions, with many possible overlaps. Hyperkeratosis refers to the increased thickness of the stratum corneum, the outer layer of the skin. Hyperkeratosis is subclassified as orthokeratotic or parakeratotic. Orthokeratotic hyperkeratosis refers to the thickening of the keratin layer with preserved keratinocyte maturation, while parakeratotic hyperkeratosis shows retained nuclei as a sign of delayed maturation of keratinocytes. Evidence: PCS. Frequency: 2/2. (PMID:29496980)